- Chronic rhinitis (HP:0002257): Chronic inflammation of the nasal mucosa. Evidence: PCS. Frequency: 3/3. (PMID:33389130)
- Situs inversus totalis (HP:0001696): A left-right reversal (or mirror reflection) of the anatomical location of the major thoracic and abdominal organs. Evidence: PCS. Frequency: 1/3. (PMID:33389130)
- Bronchiectasis (HP:0002110): Persistent abnormal dilatation of the bronchi owing to localized and irreversible destruction and widening of the large airways. Evidence: PCS. Frequency: 3/3. (PMID:33389130)
- Male infertility (HP:0003251). Evidence: PCS. Frequency: 3/3. Onset: Young adult onset (HP:0011462). (PMID:33389130)
- Decreased nasal nitric oxide (HP:0033036): Reduced level of nasal nitric oxide (nNO). Current American Thoracic Society/European Respiratory Society (ATS/ERS) guidelines for nNO measurements recommend air aspiration via a nasal probe while the subject exhales through the mouth against resistance in order to maintain velum closure. Evidence: PCS. Frequency: 1/2. (PMID:33389130)
- Reduced sperm motility (HP:0012207): An abnormal reduction in the mobility of ejaculated sperm. Evidence: PCS. Frequency: 3/3. (PMID:33389130)
- Productive cough (HP:0031245): A cough that produces phlegm or mucus. Evidence: PCS. Frequency: 3/3. (PMID:33389130)
- Recurrent sinusitis (HP:0011108): A recurrent form of sinusitis. Evidence: PCS. Frequency: 3/3. (PMID:33389130)
- Absent sperm flagella (HP:0032558): Sperm cells lacking flagella. Evidence: PCS. Frequency: 3/3. (PMID:33389130)
- Short sperm flagella (HP:0032559): Sperm cells with abnormally short flagella. Evidence: PCS. Frequency: 3/3. (PMID:33389130)
- Irregularly shaped sperm tail (HP:0033393): Irregular or changing caliber (diameter) along the tail of the sperm. Evidence: PCS. Frequency: 3/3. (PMID:33389130)
- Reduced progressive sperm motility (HP:0034011): A reduced proportion of sperm that move in a straight line or large circles; alternatively, an increased proportion of sperm that move in tight circles or in some other non-linear fashion. Evidence: PCS. Frequency: 3/3. (PMID:33389130)
- Childhood onset (HP:0011463): Onset of disease at the age of between 1 and 5 years. Evidence: PCS. Frequency: 3/3. (PMID:33389130)
- Autosomal recessive inheritance (HP:0000007): A mode of inheritance that is observed for traits related to a gene encoded on one of the autosomes (i.e., the human chromosomes 1-22) in which a trait manifests in individuals with two pathogenic alleles, either homozygotes (two copies of the same mutant allele) or compound heterozygotes (whereby each copy of a gene has a distinct mutant allele). Evidence: PCS. (PMID:33389130)
- Recurrent respiratory infections (HP:0002205): An increased susceptibility to respiratory infections as manifested by a history of recurrent respiratory infections. Evidence: PCS. Frequency: 3/3. (PMID:33389130)
- Oligozoospermia (HP:0000798): Reduced count of spermatozoa in the semen, defined as a sperm count below 20 million per milliliter semen. Evidence: PCS. Frequency: 2/3. (PMID:33389130)
These phenotypes are associated with the disease ciliary dyskinesia, primary, 51 (OMIM:620438).